Phenotypes associated with the disease complex cortical dysplasia with other brain malformations 3 (OMIM:615411):
- Spastic tetraplegia (HP:0002510): Spastic paralysis affecting all four limbs. Evidence: TAS. (OMIM:615411)
- Microcephaly (HP:0000252): Head circumference below 2 standard deviations below the mean for age and gender. Evidence: PCS. Frequency: 2/2. (PMID:23603762)
- Subcortical band heterotopia (HP:0032409): A form of subcortical heterotopia with mislocalized gray matter within the white matter.It is defined as longitudinal bands of gray matter located deep to the cerebral cortex and separated from it by a thin layer of normal appearing white matter. It is part of the lissencephaly spectrum. Evidence: PCS. Frequency: 1/2. (PMID:23603762)
- Hypoplasia of the corpus callosum (HP:0002079): Underdevelopment of the corpus callosum. Evidence: PCS. Frequency: 2/2. (PMID:23603762)
- Seizure (HP:0001250): A seizure is an intermittent abnormality of nervous system physiology characterized by a transient occurrence of signs and/or symptoms due to abnormal excessive or synchronous neuronal activity in the brain. Evidence: PCS. Frequency: 2/2. (PMID:23603762)
- Global developmental delay (HP:0001263): A delay in the achievement of motor or mental milestones in the domains of development of a child, including motor skills, speech and language, cognitive skills, and social and emotional skills. This term should only be used to describe children younger than five years of age. Evidence: PCS. Frequency: 2/2. (PMID:23603762)
- Gray matter heterotopia (HP:0002282): Heterotopia or neuronal heterotopia are macroscopic clusters of misplaced neurons (gray matter), most often situated along the ventricular walls or within the subcortical white matter. Evidence: IEA. (OMIM:615411)
- Agyria (HP:0031882): A congenital abnormality of the cerebral hemisphere characterized by lack of gyrations (convolutions) of the cerebral cortex. Agyria is defined as cortical regions lacking gyration with sulci great than 3 cm apart and cerebral cortex thicker than 5 mm. Evidence: PCS. Frequency: 1/2. (PMID:23603762)
- Thin corpus callosum (HP:0033725): An abnormally thin corpus callous, due to atrophy, hypoplasia or agenesis. This term is intended to be used in situations where it is not known if thinning of the corpus callosum (for instance, as visualized by magnetic resonance tomography) is due to abnormal development (e.g. a leukodystrophy) or atrophy following normal development (e.g. neurodegeneration). Evidence: PCS. Frequency: 2/2. (PMID:23603762)
- Nystagmus (HP:0000639): Rhythmic, involuntary oscillations of one or both eyes related to abnormality in fixation, conjugate gaze, or vestibular mechanisms. Evidence: TAS. Frequency: Occasional (HP:0040283). (OMIM:615411)
- Lissencephaly (HP:0001339): A spectrum of malformations of cortical development caused by insufficient neuronal migration that subsumes the terms agyria, pachygyria and subcortical band heterotopia. See also neuropathological definitions for 2-, 3-, and 4-layered lissencephaly. Evidence: TAS. (OMIM:615411)
- Cortical dysplasia (HP:0002539): The presence of developmental dysplasia of the cerebral cortex. Evidence: IEA. (OMIM:615411)
- Pachygyria (HP:0001302): Pachygyria is a malformation of cortical development with abnormally wide gyri with sulci 1,5-3 cm apart and abnormally thick cortex measuring more than 5 mm (radiological definition). See also neuropathological definitions for 2-, 3-, and 4-layered lissencephaly. Evidence: PCS. Frequency: 2/2. (PMID:23603762)
- Intrauterine growth retardation (HP:0001511): An abnormal restriction of fetal growth with fetal weight below the tenth percentile for gestational age. Evidence: TAS. Frequency: Occasional (HP:0040283). (OMIM:615411)
- Autosomal dominant inheritance (HP:0000006): A mode of inheritance that is observed for traits related to a gene encoded on one of the autosomes (i.e., the human chromosomes 1-22) in which a trait manifests in heterozygotes. In the context of medical genetics, an autosomal dominant disorder is caused when a single copy of the mutant allele is present. Males and females are affected equally, and can both transmit the disorder with a risk of 50% for each child of inheriting the mutant allele. Evidence: PCS. (PMID:23603762)